Phenotypes associated with the disease pigmented nodular adrenocortical disease, primary, 3 (OMIM:614190):
- Adrenal hyperplasia (HP:0008221): Enlargement of the adrenal gland. Evidence: TAS. (OMIM:614190)
- Increased circulating cortisol level (HP:0003118): Overproduction of the hormone of cortisol by the adrenal cortex, resulting in a characteristic combination of clinical symptoms termed Cushing syndrome, with truncal obesity, a round, full face, striae atrophicae and acne, muscle weakness, and other features. Evidence: TAS. (OMIM:614190)
- Autosomal dominant inheritance (HP:0000006): A mode of inheritance that is observed for traits related to a gene encoded on one of the autosomes (i.e., the human chromosomes 1-22) in which a trait manifests in heterozygotes. In the context of medical genetics, an autosomal dominant disorder is caused when a single copy of the mutant allele is present. Males and females are affected equally, and can both transmit the disorder with a risk of 50% for each child of inheriting the mutant allele. Evidence: TAS. (OMIM:614190)